Phenotypes associated with the disease autosomal dominant nonsyndromic hearing loss 28 (OMIM:608641):
- Progressive (HP:0003676): Applies to a disease manifestation that increases in scope or severity over the course of time, i.e., that worsens with age. Evidence: TAS. (OMIM:608641)
- Sensorineural hearing impairment (HP:0000407): A type of hearing impairment in one or both ears related to an abnormal functionality of the cochlear nerve. Evidence: TAS. (OMIM:608641)
- Autosomal dominant inheritance (HP:0000006): A mode of inheritance that is observed for traits related to a gene encoded on one of the autosomes (i.e., the human chromosomes 1-22) in which a trait manifests in heterozygotes. In the context of medical genetics, an autosomal dominant disorder is caused when a single copy of the mutant allele is present. Males and females are affected equally, and can both transmit the disorder with a risk of 50% for each child of inheriting the mutant allele. Evidence: TAS. (OMIM:608641)